- Cavum septum pellucidum (HP:0002389): If the two laminae of the septum pellucidum are not fused then a fluid-filled space or cavum is present. The cavum septum pellucidum is present at birth but usually obliterates by the age of 3 to 6 months. It is up to 1cm in width and the walls are parallel. It is an enclosed space and is not part of the ventricular system or connected with the subarachnoid space. Evidence: PCS. (PMID:23159249)
- Abnormal cardiac septum morphology (HP:0001671): An anomaly of the intra-atrial or intraventricular septum. Evidence: TAS. Frequency: Occasional (HP:0040283). (OMIM:615009)
- Large hands (HP:0001176). Evidence: IEA. (OMIM:615009)
- Strabismus (HP:0000486): A misalignment of the eyes so that the visual axes deviate from bifoveal fixation. The classification of strabismus may be based on a number of features including the relative position of the eyes, whether the deviation is latent or manifest, intermittent or constant, concomitant or otherwise and according to the age of onset and the relevance of any associated refractive error. Evidence: TAS. (OMIM:615009)
- Single umbilical artery (HP:0001195): Single umbilical artery (SUA) is the absence of one of the two umbilical arteries surrounding the fetal bladder and in the fetal umbilical cord. Evidence: PCS. (PMID:23159249)
- Seizure (HP:0001250): A seizure is an intermittent abnormality of nervous system physiology characterized by a transient occurrence of signs and/or symptoms due to abnormal excessive or synchronous neuronal activity in the brain. Evidence: PCS. (PMID:23159249)
- Volvulus (HP:0002580): Abnormal twisting of a portion of intestine around itself or around a stalk of mesentery tissue. Evidence: PCS. (PMID:23159249)
- Generalized hypotonia (HP:0001290): Generalized muscular hypotonia (abnormally low muscle tone). Evidence: TAS. (OMIM:615009)
- Nystagmus (HP:0000639): Rhythmic, involuntary oscillations of one or both eyes related to abnormality in fixation, conjugate gaze, or vestibular mechanisms. Evidence: TAS. (OMIM:615009)
- Smooth philtrum (HP:0000319): Flat skin surface, with no ridge formation in the central region of the upper lip between the nasal base and upper vermilion border. Evidence: PCS. (PMID:23159249)
- Aggressive behavior (HP:0000718): Behavior or an act aimed at harming a person, animal, or physical property (e.g., acts of physical violence; shouting, swearing, and using harsh language; slashing someone's tires). Evidence: TAS. (OMIM:615009)
- Hypertelorism (HP:0000316): Interpupillary distance more than 2 SD above the mean (alternatively, the appearance of an increased interpupillary distance or widely spaced eyes). Evidence: PCS. (PMID:23159249)
- Bicuspid aortic valve (HP:0001647): The presence of an aortic valve with two instead of the normal three cusps (flaps). Bicuspid aortic valvue is a malformation of a commissure (small space between the attachment of each cusp to the aortic wall) and the adjacent parts of the two corresponding cusps forming a raphe (the fused area of the two underdeveloped cusps turning into a malformed commissure between both cusps; the raphe is a fibrous ridge that extends from the commissure to the free edge of the two underdeveloped, conjoint cusps). Evidence: IEA. (OMIM:615009)
- Bulbous nose (HP:0000414): Increased volume and globular shape of the anteroinferior aspect of the nose. Evidence: PCS. (PMID:23159249)
- Thin upper lip vermilion (HP:0000219): Height of the vermilion of the upper lip in the midline more than 2 SD below the mean. Alternatively, an apparently reduced height of the vermilion of the upper lip in the frontal view (subjective). Evidence: TAS. (OMIM:615009)
- Downturned corners of mouth (HP:0002714): A morphological abnormality of the mouth in which the angle of the mouth is downturned. The oral commissures are positioned inferior to the midline labial fissure. Evidence: TAS. (OMIM:615009)
- Wide intermamillary distance (HP:0006610): A larger than usual distance between the left and right nipple. Evidence: PCS. (PMID:23159249)
- Patent ductus arteriosus (HP:0001643): In utero, the ductus arteriosus (DA) serves to divert ventricular output away from the lungs and toward the placenta by connecting the main pulmonary artery to the descending aorta. A patent ductus arteriosus (PDA) in the first 3 days of life is a physiologic shunt in healthy term and preterm newborn infants, and normally is substantially closed within about 24 hours after bith and completely closed after about three weeks. Failure of physiologcal closure is referred to a persistent or patent ductus arteriosus (PDA). Depending on the degree of left-to-right shunting, PDA can have clinical consequences. Evidence: IEA. (OMIM:615009)
- Pes planus (HP:0001763): A foot where the longitudinal arch of the foot is in contact with the ground or floor when the individual is standing; or, in a patient lying supine, a foot where the arch is in contact with the surface of a flat board pressed against the sole of the foot by the examiner with a pressure similar to that expected from weight bearing; or, the height of the arch is reduced. Evidence: PCS. (PMID:23159249)
- Constipation (HP:0002019): Infrequent or difficult evacuation of feces. Evidence: TAS. (OMIM:615009)
- Intellectual disability (HP:0001249): The term intellectual disability or intellectual developmental disorder is used to describe significantly sub-average intellectual and adaptive functioning based on clinical assessment and as measured by individually administered, appropriately normed, standardized and validated tests of intellectual functioning and adaptive behavior, with onset during the developmental period from infancy through adolescence. Evidence: PCS. (PMID:23159249)
- Diastema (HP:0000699): Increased space between two adjacent teeth in the same dental arch. Evidence: TAS. (OMIM:615009)
- Highly arched eyebrow (HP:0002553): Increased height of the central portion of the eyebrow, forming a crescent, semicircular, or inverted U shape. Evidence: PCS. (PMID:23159249)
- Wide mouth (HP:0000154): Distance between the oral commissures more than 2 SD above the mean. Alternatively, an apparently increased width of the oral aperture (subjective). Evidence: TAS. (OMIM:615009)
- Downslanted palpebral fissures (HP:0000494): The palpebral fissure inclination is more than two standard deviations below the mean. Evidence: PCS. (PMID:23159249)
- Delayed speech and language development (HP:0000750): A degree of language development that is significantly below the norm for a child of a specified age. Evidence: TAS. (OMIM:615009)
- Absent speech (HP:0001344): Complete lack of development of speech and language abilities. Evidence: IEA. (OMIM:615009)
- Cerebellar hypoplasia (HP:0001321): Cerebellar hypoplasia is a descriptive term implying a cerebellum with a reduced volume, but a normal shape and is stable over time. Evidence: TAS. Frequency: Occasional (HP:0040283). (OMIM:615009)
- Feeding difficulties (HP:0011968): Impaired ability to eat related to problems gathering food and getting ready to suck, chew, or swallow it. Evidence: TAS. (OMIM:615009)
- Global developmental delay (HP:0001263): A delay in the achievement of motor or mental milestones in the domains of development of a child, including motor skills, speech and language, cognitive skills, and social and emotional skills. This term should only be used to describe children younger than five years of age. Evidence: PCS. (PMID:23159249)
- Low anterior hairline (HP:0000294): Distance between the hairline (trichion) and the glabella (the most prominent point on the frontal bone above the root of the nose), in the midline, more than two SD below the mean. Alternatively, an apparently decreased distance between the hairline and the glabella. Evidence: PCS. (PMID:23159249)
- Speech apraxia (HP:0011098): A type of apraxia that is characterized by difficulty or inability to execute speech movements because of problems with coordination and motor problems, leading to incorrect articulation. An increase of errors with increasing word and phrase length may occur. Evidence: PCS. (PMID:23159249)
- Ptosis (HP:0000508): The upper eyelid margin is positioned 3 mm or more lower than usual and covers the superior portion of the iris (objective); or, the upper lid margin obscures at least part of the pupil (subjective). Evidence: TAS. (OMIM:615009)
- Long foot (HP:0001833): Increased back to front length of the foot. Evidence: IEA. (OMIM:615009)
- Long eyelashes (HP:0000527): Mid upper eyelash length >10 mm or increased length of the eyelashes (subjective). Evidence: PCS. (PMID:23159249)
- Synophrys (HP:0000664): Meeting of the medial eyebrows in the midline. Evidence: PCS. (PMID:23159249)
- Macrotia (HP:0000400): Median longitudinal ear length greater than two standard deviations above the mean and median ear width greater than two standard deviations above the mean (objective); or, apparent increase in length and width of the pinna (subjective). Evidence: PCS. (PMID:23159249)
- Autosomal dominant inheritance (HP:0000006): A mode of inheritance that is observed for traits related to a gene encoded on one of the autosomes (i.e., the human chromosomes 1-22) in which a trait manifests in heterozygotes. In the context of medical genetics, an autosomal dominant disorder is caused when a single copy of the mutant allele is present. Males and females are affected equally, and can both transmit the disorder with a risk of 50% for each child of inheriting the mutant allele. Evidence: PCS. (PMID:23159249)
- Low-set ears (HP:0000369): Upper insertion of the ear to the scalp below an imaginary horizontal line drawn between the inner canthi of the eye and extending posteriorly to the ear. Evidence: PCS. (PMID:23159249)
- Cryptorchidism (HP:0000028): Testis in inguinal canal. That is, absence of one or both testes from the scrotum owing to failure of the testis or testes to descend through the inguinal canal to the scrotum. Evidence: PCS. (PMID:23159249)
- Myopia (HP:0000545): An abnormality of refraction characterized by the ability to see objects nearby clearly, while objects in the distance appear blurry. Evidence: TAS. (OMIM:615009)
- Patent foramen ovale (HP:0001655): Failure of the foramen ovale to seal postnatally, leaving a potential conduit between the left and right cardiac atria. Evidence: IEA. (OMIM:615009)
These phenotypes are associated with the disease Schuurs-Hoeijmakers syndrome (OMIM:615009).